Phenotypes associated with the disease 3q29 microdeletion syndrome (ORPHA:65286):
- Hypospadias (HP:0000047): Abnormal position of urethral meatus on the ventral penile shaft (underside) characterized by displacement of the urethral meatus from the tip of the glans penis to the ventral surface of the penis, scrotum, or perineum. Evidence: TAS. Frequency: Occasional (HP:0040283). (ORPHA:65286)
- Horseshoe kidney (HP:0000085): A connection of the right and left kidney by an isthmus of functioning renal parenchyma or fibrous tissue that crosses the midline. Evidence: TAS. Frequency: Occasional (HP:0040283). (ORPHA:65286)
- Abnormality of the dentition (HP:0000164): Any abnormality of the teeth. Evidence: TAS. Frequency: Occasional (HP:0040283). (ORPHA:65286)
- Orofacial cleft (HP:0000202): The presence of a cleft (gap, opening, or groove) in the oral cavity, including cleft of the upper lip and/or cleft of the palate. Cleft of the upper lip is visible as a groove or fissure in the lip, most frequently due to a congenital failure of the maxillary and median nasal processes to fuse. Cleft palate is characterized by a grooved depression or fissure in the roof of the mouth, most often resulting from a congenital failure of the palate to fuse properly. Clefts of the lip and palate can occur individually or together. It is preferable to code each defect separately. Evidence: TAS. Frequency: Occasional (HP:0040283). (ORPHA:65286)
- High palate (HP:0000218): Height of the palate more than 2 SD above the mean (objective) or palatal height at the level of the first permanent molar more than twice the height of the teeth (subjective). Evidence: TAS. Frequency: Occasional (HP:0040283). (ORPHA:65286)
- Everted lower lip vermilion (HP:0000232): An abnormal configuration of the lower lip such that it is turned outward i.e., everted, with the Inner aspect of the lower lip vermilion (normally opposing the teeth) being visible in a frontal view. Evidence: TAS. Frequency: Frequent (HP:0040282). (ORPHA:65286)
- Microcephaly (HP:0000252): Head circumference below 2 standard deviations below the mean for age and gender. Evidence: TAS. Frequency: Frequent (HP:0040282). (ORPHA:65286)
- Macrocephaly (HP:0000256): Occipitofrontal (head) circumference greater than 97th centile compared to appropriate, age matched, sex-matched normal standards. Alternatively, a apparently increased size of the cranium. Evidence: TAS. Frequency: Occasional (HP:0040283). (ORPHA:65286)
- Narrow face (HP:0000275): Bizygomatic (upper face) and bigonial (lower face) width are both more than 2 standard deviations below the mean (objective); or, an apparent reduction in the width of the upper and lower face (subjective). Evidence: TAS. Frequency: Occasional (HP:0040283). (ORPHA:65286)
- Long face (HP:0000276): Facial height (length) is more than 2 standard deviations above the mean (objective); or, an apparent increase in the height (length) of the face (subjective). Evidence: TAS. Frequency: Occasional (HP:0040283). (ORPHA:65286)
- Short philtrum (HP:0000322): Distance between nasal base and midline upper lip vermilion border more than 2 SD below the mean. Alternatively, an apparently decreased distance between nasal base and midline upper lip vermilion border. Evidence: TAS. Frequency: Frequent (HP:0040282). (ORPHA:65286)
- Facial asymmetry (HP:0000324): An abnormal difference between the left and right sides of the face. Evidence: TAS. Frequency: Occasional (HP:0040283). (ORPHA:65286)
- Low-set ears (HP:0000369): Upper insertion of the ear to the scalp below an imaginary horizontal line drawn between the inner canthi of the eye and extending posteriorly to the ear. Evidence: TAS. Frequency: Frequent (HP:0040282). (ORPHA:65286)
- Macrotia (HP:0000400): Median longitudinal ear length greater than two standard deviations above the mean and median ear width greater than two standard deviations above the mean (objective); or, apparent increase in length and width of the pinna (subjective). Evidence: TAS. Frequency: Frequent (HP:0040282). (ORPHA:65286)
- Prominent nasal bridge (HP:0000426): Anterior positioning of the nasal root in comparison to the usual positioning for age. Evidence: TAS. Frequency: Frequent (HP:0040282). (ORPHA:65286)
- Downslanted palpebral fissures (HP:0000494): The palpebral fissure inclination is more than two standard deviations below the mean. Evidence: TAS. Frequency: Occasional (HP:0040283). (ORPHA:65286)
- Cataract (HP:0000518): A cataract is an opacity or clouding that develops in the crystalline lens of the eye or in its capsule. Evidence: TAS. Frequency: Occasional (HP:0040283). (ORPHA:65286)
- Microphthalmia (HP:0000568): A developmental anomaly characterized by abnormal smallness of one or both eyes. Evidence: TAS. Frequency: Occasional (HP:0040283). (ORPHA:65286)
- Dental crowding (HP:0000678): Changes in alignment of teeth in the dental arch. Evidence: TAS. Frequency: Occasional (HP:0040283). (ORPHA:65286)
- Psychosis (HP:0000709): A condition characterized by changes in personality and thought patterns, often accompanied by hallucinations and delusional beliefs, is known as psychosis. Evidence: TAS. Frequency: Occasional (HP:0040283). (ORPHA:65286)
- Depression (HP:0000716): Frequently experiencing feelings of being down, miserable, and/or hopeless; struggling to recover from these moods; having a pessimistic outlook on the future; feeling a pervasive sense of shame; having a low self-worth; experiencing thoughts of suicide and engaging in suicidal behavior. Evidence: TAS. Frequency: Occasional (HP:0040283). (ORPHA:65286)
- Autism (HP:0000717): Autism is a neurodevelopmental disorder characterized by impaired social interaction and communication, and by restricted and repetitive behavior. Autism begins in childhood. It is marked by the presence of markedly abnormal or impaired development in social interaction and communication and a markedly restricted repertoire of activity and interest. Manifestations of the disorder vary greatly depending on the developmental level and chronological age of the individual (DSM-IV). Evidence: TAS. Frequency: Occasional (HP:0040283). (ORPHA:65286)
- Aggressive behavior (HP:0000718): Behavior or an act aimed at harming a person, animal, or physical property (e.g., acts of physical violence; shouting, swearing, and using harsh language; slashing someone's tires). Evidence: TAS. Frequency: Occasional (HP:0040283). (ORPHA:65286)
- Anxiety (HP:0000739): Intense feelings of nervousness, tension, or panic often arise in response to interpersonal stresses. There is worry about the negative effects of past unpleasant experiences and future negative possibilities. Individuals may feel fearful, apprehensive, or threatened by uncertainty, and they may also have fears of falling apart or losing control. Evidence: TAS. Frequency: Occasional (HP:0040283). (ORPHA:65286)
- Delayed speech and language development (HP:0000750): A degree of language development that is significantly below the norm for a child of a specified age. Evidence: TAS. Frequency: Frequent (HP:0040282). (ORPHA:65286)
- Pectus excavatum (HP:0000767): A defect of the chest wall characterized by a depression of the sternum, giving the chest ("pectus") a caved-in ("excavatum") appearance. Evidence: TAS. Frequency: Occasional (HP:0040283). (ORPHA:65286)
- Pectus carinatum (HP:0000768): A deformity of the chest caused by overgrowth of the ribs and characterized by protrusion of the sternum. Evidence: TAS. Frequency: Occasional (HP:0040283). (ORPHA:65286)
- Abnormal skin pigmentation (HP:0001000): An abnormality of the pigmentation of the skin. Evidence: TAS. Frequency: Occasional (HP:0040283). (ORPHA:65286)
- Tapered finger (HP:0001182): The gradual reduction in girth of the finger from proximal to distal. Evidence: TAS. Frequency: Occasional (HP:0040283). (ORPHA:65286)
- Intellectual disability (HP:0001249): The term intellectual disability or intellectual developmental disorder is used to describe significantly sub-average intellectual and adaptive functioning based on clinical assessment and as measured by individually administered, appropriately normed, standardized and validated tests of intellectual functioning and adaptive behavior, with onset during the developmental period from infancy through adolescence. Evidence: TAS. Frequency: Very frequent (HP:0040281). (ORPHA:65286)
- Global developmental delay (HP:0001263): A delay in the achievement of motor or mental milestones in the domains of development of a child, including motor skills, speech and language, cognitive skills, and social and emotional skills. This term should only be used to describe children younger than five years of age. Evidence: TAS. Frequency: Very frequent (HP:0040281). (ORPHA:65286)
- Gait disturbance (HP:0001288): The term gait disturbance can refer to any disruption of the ability to walk. Evidence: TAS. Frequency: Occasional (HP:0040283). (ORPHA:65286)
- Failure to thrive (HP:0001508): Failure to thrive (FTT) refers to a child whose physical growth is substantially below the norm. Evidence: TAS. Frequency: Occasional (HP:0040283). (ORPHA:65286)
- Hypernasal speech (HP:0001611): A type of speech characterized by the presence of an abnormally increased nasal airflow during speech associated with structural abnormality of the nasal passages. Evidence: TAS. Frequency: Occasional (HP:0040283). (ORPHA:65286)
- Patent ductus arteriosus (HP:0001643): In utero, the ductus arteriosus (DA) serves to divert ventricular output away from the lungs and toward the placenta by connecting the main pulmonary artery to the descending aorta. A patent ductus arteriosus (PDA) in the first 3 days of life is a physiologic shunt in healthy term and preterm newborn infants, and normally is substantially closed within about 24 hours after bith and completely closed after about three weeks. Failure of physiologcal closure is referred to a persistent or patent ductus arteriosus (PDA). Depending on the degree of left-to-right shunting, PDA can have clinical consequences. Evidence: TAS. Frequency: Occasional (HP:0040283). (ORPHA:65286)
- Subvalvular aortic stenosis (HP:0001682): A fixed form of obstruction to blood flow across the left-ventricular outflow tract related to stenosis (narrowing) below the level of the aortic valve. Evidence: TAS. Frequency: Occasional (HP:0040283). (ORPHA:65286)
- Gastroesophageal reflux (HP:0002020): A condition in which the stomach contents leak backwards from the stomach into the esophagus through the lower esophageal sphincter. Evidence: TAS. Frequency: Occasional (HP:0040283). (ORPHA:65286)
- Pulmonary arterial hypertension (HP:0002092): Pulmonary hypertension is defined mean pulmonary artery pressure of 25mmHg or more and pulmonary capillary wedge pressure of 15mmHg or less when measured by right heart catheterisation at rest and in a supine position. Evidence: TAS. Frequency: Occasional (HP:0040283). (ORPHA:65286)
- Short nose (HP:0003196): Distance from nasion to subnasale more than two standard deviations below the mean, or alternatively, an apparently decreased length from the nasal root to the nasal tip. Evidence: TAS. Frequency: Occasional (HP:0040283). (ORPHA:65286)
- Clinodactyly of the 5th finger (HP:0004209): Clinodactyly refers to a bending or curvature of the fifth finger in the radial direction (i.e., towards the 4th finger). Evidence: TAS. Frequency: Occasional (HP:0040283). (ORPHA:65286)
- Attention deficit hyperactivity disorder (HP:0007018): Attention deficit hyperactivity disorder (ADHD) manifests at age 2-3 years or by first grade at the latest. The main symptoms are distractibility, impulsivity, hyperactivity, and often trouble organizing tasks and projects, difficulty going to sleep, and social problems from being aggressive, loud, or impatient. Evidence: TAS. Frequency: Occasional (HP:0040283). (ORPHA:65286)
- Bipolar affective disorder (HP:0007302): Bipolar disorder is an illness of mood characterized by alternating episodes of elevated and depressed moods, which are interspersed with euthymic periods. Evidence: TAS. Frequency: Occasional (HP:0040283). (ORPHA:65286)
- Six lumbar vertebrae (HP:0008416). Evidence: TAS. Frequency: Occasional (HP:0040283). (ORPHA:65286)
- Joint hypermobility (HP:0001382): The capability that a joint (or a group of joints) has to move, passively and/or actively, beyond normal limits along physiological axes. Evidence: TAS. Frequency: Occasional (HP:0040283). (ORPHA:65286)